Phenotypes associated with the disease microcephaly and chorioretinopathy 1 (OMIM:251270):
- Abnormal retinal pigmentation (HP:0007703): Any deviation from the normal pigmentation of the retina. Evidence: TAS. (OMIM:251270)
- Microcephaly (HP:0000252): Head circumference below 2 standard deviations below the mean for age and gender. Evidence: IEA. (OMIM:251270)
- Abnormal skin pigmentation (HP:0001000): An abnormality of the pigmentation of the skin. Evidence: IEA. (OMIM:251270)
- Sloping forehead (HP:0000340): Inclination of the anterior surface of the forehead from the vertical more than two standard deviations above the mean (objective); or apparently excessive posterior sloping of the forehead in a lateral view. Evidence: TAS. (OMIM:251270)
- Cerebral atrophy (HP:0002059): Atrophy (wasting, decrease in size of cells or tissue) affecting the cerebrum. Evidence: TAS. (OMIM:251270)
- Congenital onset (HP:0003577): A phenotypic abnormality that is present at birth. Evidence: TAS. (OMIM:251270)
- Retinal detachment (HP:0000541): Separation of the inner layers of the retina (neural retina) from the pigment epithelium. Evidence: TAS. (OMIM:251270)
- Short stature (HP:0004322): A height below that which is expected according to age and gender norms. Although there is no universally accepted definition of short stature, many refer to "short stature" as height more than 2 standard deviations below the mean for age and gender (or below the 3rd percentile for age and gender dependent norms). Evidence: TAS. (OMIM:251270)
- Cerebellar hypoplasia (HP:0001321): Cerebellar hypoplasia is a descriptive term implying a cerebellum with a reduced volume, but a normal shape and is stable over time. Evidence: TAS. (OMIM:251270)
- Seizure (HP:0001250): A seizure is an intermittent abnormality of nervous system physiology characterized by a transient occurrence of signs and/or symptoms due to abnormal excessive or synchronous neuronal activity in the brain. Evidence: TAS. Frequency: Occasional (HP:0040283). (OMIM:251270)
- Global developmental delay (HP:0001263): A delay in the achievement of motor or mental milestones in the domains of development of a child, including motor skills, speech and language, cognitive skills, and social and emotional skills. This term should only be used to describe children younger than five years of age. Evidence: TAS. (OMIM:251270)
- Retinal fold (HP:0008052): A wrinkle of retinal tissue projecting outward from the surface of the retina and visible as a line on fundoscopy. Evidence: TAS. (OMIM:251270)
- Cataract (HP:0000518): A cataract is an opacity or clouding that develops in the crystalline lens of the eye or in its capsule. Evidence: IEA. (OMIM:251270)
- Nystagmus (HP:0000639): Rhythmic, involuntary oscillations of one or both eyes related to abnormality in fixation, conjugate gaze, or vestibular mechanisms. Evidence: TAS. Frequency: Occasional (HP:0040283). (OMIM:251270)
- Autosomal recessive inheritance (HP:0000007): A mode of inheritance that is observed for traits related to a gene encoded on one of the autosomes (i.e., the human chromosomes 1-22) in which a trait manifests in individuals with two pathogenic alleles, either homozygotes (two copies of the same mutant allele) or compound heterozygotes (whereby each copy of a gene has a distinct mutant allele). Evidence: IEA. (OMIM:251270)
- Microphthalmia (HP:0000568): A developmental anomaly characterized by abnormal smallness of one or both eyes. Evidence: IEA. (OMIM:251270)
- Visual impairment (HP:0000505): Visual impairment (or vision impairment) is vision loss (of a person) to such a degree as to qualify as an additional support need through a significant limitation of visual capability resulting from either disease, trauma, or congenital or degenerative conditions that cannot be corrected by conventional means, such as refractive correction, medication, or surgery. Evidence: TAS. (OMIM:251270)
- Chorioretinal dysplasia (HP:0007731): Abnormal development of the choroid and retina. Evidence: PCS. (PMID:11146476)
- Optic disc pallor (HP:0000543): A pale yellow discoloration of the optic disc (the area of the optic nerve head in the retina). The optic disc normally has a pinkish hue with a central yellowish depression. Evidence: IEA. (OMIM:251270)
- Pachygyria (HP:0001302): Pachygyria is a malformation of cortical development with abnormally wide gyri with sulci 1,5-3 cm apart and abnormally thick cortex measuring more than 5 mm (radiological definition). See also neuropathological definitions for 2-, 3-, and 4-layered lissencephaly. Evidence: TAS. (OMIM:251270)
- Intellectual disability (HP:0001249): The term intellectual disability or intellectual developmental disorder is used to describe significantly sub-average intellectual and adaptive functioning based on clinical assessment and as measured by individually administered, appropriately normed, standardized and validated tests of intellectual functioning and adaptive behavior, with onset during the developmental period from infancy through adolescence. Evidence: IEA. (OMIM:251270)
- Retinal dystrophy (HP:0000556): Retinal dystrophy is an abnormality of the retina associated with a hereditary process. Retinal dystrophies are defined by their predominantly monogenic inheritance and they are frequently associated with loss or dysfunction of photoreceptor cells as a primary or secondary event. Evidence: TAS. (OMIM:251270)
- Simplified gyral pattern (HP:0009879): An abnormality of the cerebral cortex with fewer gyri but with normal cortical thickness. This pattern is usually often associated with congenital microcephaly. Evidence: TAS. (OMIM:251270)